- Decreased circulating C-peptide concentration (HP:0030795): The concentration of C-peptide in the blood circulation is below the lower limit of normal. Evidence: PCS. (PMID:26101329)
- Small for gestational age (HP:0001518): Smaller than normal size according to sex and gestational age related norms, defined as a weight below the 10th percentile for the gestational age. Evidence: PCS. Onset: Congenital onset (HP:0003577). (PMID:17855560)
- Hyperglycemia (HP:0003074): An increased concentration of glucose in the blood. Evidence: PCS. Onset: Neonatal onset (HP:0003623). (PMID:17855560)
- Autosomal recessive inheritance (HP:0000007): A mode of inheritance that is observed for traits related to a gene encoded on one of the autosomes (i.e., the human chromosomes 1-22) in which a trait manifests in individuals with two pathogenic alleles, either homozygotes (two copies of the same mutant allele) or compound heterozygotes (whereby each copy of a gene has a distinct mutant allele). Evidence: PCS. (PMID:26101329)
- Type I diabetes mellitus (HP:0100651): A chronic condition in which the pancreas produces little or no insulin. Type I diabetes mellitus is manifested by the sudden onset of severe hyperglycemia with rapid progression to diabetic ketoacidosis unless treated with insulin. Evidence: PCS. Onset: Neonatal onset (HP:0003623). (PMID:17855560)
- Elevated hemoglobin A1c (HP:0040217): An increased concentration of hemoglobin A1c (HbA1c), which is the product of nonenzymatic attachment of a hexose molecule to the N-terminal amino acid of the hemoglobin molecule. This reaction is dependent on blood glucose concentration, and therefore reflects the mean glucose concentration over the previous 8 to 12 weeks. The HbA1c level provides a better indication of long-term glycemic control than one-time blood or urinary glucose measurements. Evidence: PCS. (PMID:17855560)
- Autosomal dominant inheritance (HP:0000006): A mode of inheritance that is observed for traits related to a gene encoded on one of the autosomes (i.e., the human chromosomes 1-22) in which a trait manifests in heterozygotes. In the context of medical genetics, an autosomal dominant disorder is caused when a single copy of the mutant allele is present. Males and females are affected equally, and can both transmit the disorder with a risk of 50% for each child of inheriting the mutant allele. Evidence: PCS. (PMID:17855560)
- Diabetic ketoacidosis (HP:0001953): A type of diabetic metabolic abnormality with an accumulation of ketone bodies. Evidence: PCS. Onset: Neonatal onset (HP:0003623). (PMID:17855560)
These phenotypes are associated with the disease diabetes mellitus, permanent neonatal 4 (OMIM:618858).